- Renal insufficiency (HP:0000083): A reduction in the level of performance of the kidneys in areas of function comprising the concentration of urine, removal of wastes, the maintenance of electrolyte balance, homeostasis of blood pressure, and calcium metabolism. Evidence: TAS. Frequency: Occasional (HP:0040283). (ORPHA:474)
- Nephronophthisis (HP:0000090): Presence of cysts at the corticomedullary junction of the kidney in combination with tubulointerstitial fibrosis. Evidence: TAS. Frequency: Occasional (HP:0040283). (ORPHA:474)
- Nephropathy (HP:0000112): A nonspecific term referring to disease or damage of the kidneys. Evidence: TAS. Frequency: Occasional (HP:0040283). (ORPHA:474)
- Abnormal sternum morphology (HP:0000766): An anomaly of the sternum, also known as the breastbone. Evidence: TAS. Frequency: Frequent (HP:0040282). (ORPHA:474)
- Abnormal rib morphology (HP:0000772): An anomaly of the rib. Evidence: TAS. Frequency: Very frequent (HP:0040281). (ORPHA:474)
- Narrow chest (HP:0000774): Reduced width of the chest from side to side, associated with a reduced distance from the sternal notch to the tip of the shoulder. Evidence: TAS. Frequency: Very frequent (HP:0040281). (ORPHA:474)
- Abnormal clavicle morphology (HP:0000889): Any abnormality of the clavicles (collar bones). Evidence: TAS. Frequency: Frequent (HP:0040282). (ORPHA:474)
- Abnormal metaphysis morphology (HP:0000944): An abnormality of one or more metaphysis, i.e., of the somewhat wider portion of a long bone that is adjacent to the epiphyseal growth plate and grows during childhood. Evidence: TAS. Frequency: Frequent (HP:0040282). (ORPHA:474)
- Brachydactyly (HP:0001156): Digits that appear disproportionately short compared to the hand/foot. The word brachydactyly is used here to describe a series distinct patterns of shortened digits (brachydactyly types A-E). This is the sense used here. Evidence: TAS. Frequency: Frequent (HP:0040282). (ORPHA:474)
- Postaxial hand polydactyly (HP:0001162): Supernumerary digits located at the ulnar side of the hand (that is, on the side with the fifth finger). Evidence: TAS. Frequency: Occasional (HP:0040283). (ORPHA:474)
- Abnormality of the liver (HP:0001392): An abnormality of the liver. Evidence: TAS. Frequency: Occasional (HP:0040283). (ORPHA:474)
- Toe syndactyly (HP:0001770): Webbing or fusion of the toes, involving soft parts only or including bone structure. Bony fusions are referred to as "bony" Syndactyly if the fusion occurs in a radio-ulnar axis. Fusions of bones of the toes in a proximo-distal axis are referred to as "Symphalangism". Evidence: TAS. Frequency: Occasional (HP:0040283). (ORPHA:474)
- Short foot (HP:0001773): A measured foot length that is more than 2 SD below the mean for a newborn of 27 - 41 weeks gestation, or foot that is less than the 3rd centile for individuals from birth to 16 years of age (objective). Alternatively, a foot that appears disproportionately short (subjective). Evidence: TAS. Frequency: Frequent (HP:0040282). (ORPHA:474)
- Postaxial foot polydactyly (HP:0001830): Polydactyly of the foot most commonly refers to the presence of six toes on one foot. Postaxial polydactyly affects the lateral ray and the duplication may range from a well-formed articulated digit to a rudimentary digit. Evidence: TAS. Frequency: Occasional (HP:0040283). (ORPHA:474)
- Respiratory insufficiency (HP:0002093). Evidence: TAS. Frequency: Frequent (HP:0040282). (ORPHA:474)
- Abnormal pelvic girdle bone morphology (HP:0002644): An abnormality of the bony pelvic girdle, which is a ring of bones connecting the vertebral column to the femurs. Evidence: TAS. Frequency: Very frequent (HP:0040281). (ORPHA:474)
- Skeletal dysplasia (HP:0002652): A general term describing features characterized by abnormal development of bones and connective tissues. Evidence: TAS. Frequency: Very frequent (HP:0040281). (ORPHA:474)
- Micromelia (HP:0002983): The presence of abnormally small extremities. Evidence: TAS. Frequency: Very frequent (HP:0040281). (ORPHA:474)
- Short stature (HP:0004322): A height below that which is expected according to age and gender norms. Although there is no universally accepted definition of short stature, many refer to "short stature" as height more than 2 standard deviations below the mean for age and gender (or below the 3rd percentile for age and gender dependent norms). Evidence: TAS. Frequency: Occasional (HP:0040283). (ORPHA:474)
- Aplasia/Hypoplasia of the lungs (HP:0006703). Evidence: TAS. Frequency: Occasional (HP:0040283). (ORPHA:474)
- Abnormal retinal pigmentation (HP:0007703): Any deviation from the normal pigmentation of the retina. Evidence: TAS. Frequency: Occasional (HP:0040283). (ORPHA:474)
- Feeding difficulties in infancy (HP:0008872): Impaired feeding performance of an infant as manifested by difficulties such as weak and ineffective sucking, brief bursts of sucking, and falling asleep during sucking. There may be difficulties with chewing or maintaining attention. Evidence: TAS. Frequency: Occasional (HP:0040283). (ORPHA:474)
- Short thorax (HP:0010306): Reduced inferior to superior extent of the thorax. Evidence: TAS. Frequency: Very frequent (HP:0040281). (ORPHA:474)
- Cone-shaped epiphysis (HP:0010579): Cone-shaped epiphyses (also known as coned epiphyses) are epiphyses that invaginate into cupped metaphyses. That is, the epiphysis has a cone-shaped distal extension resulting from increased growth of the central portion of the epiphysis relative to its periphery. Evidence: TAS. Frequency: Frequent (HP:0040282). (ORPHA:474)
These phenotypes are associated with the disease Jeune syndrome (ORPHA:474).